Phenotypes associated with the disease humerus trochlea aplasia (OMIM:191000):
- Cleft palate (HP:0000175): Cleft palate is a developmental defect of the palate resulting from a failure of fusion of the palatine processes and manifesting as a separation of the roof of the mouth (soft and hard palate). Evidence: IEA. (OMIM:191000)
- Short humerus (HP:0005792): Underdevelopment of the humerus. Evidence: IEA. (OMIM:191000)
- Autosomal dominant inheritance (HP:0000006): A mode of inheritance that is observed for traits related to a gene encoded on one of the autosomes (i.e., the human chromosomes 1-22) in which a trait manifests in heterozygotes. In the context of medical genetics, an autosomal dominant disorder is caused when a single copy of the mutant allele is present. Males and females are affected equally, and can both transmit the disorder with a risk of 50% for each child of inheriting the mutant allele. Evidence: TAS. (OMIM:191000)